- Thin vermilion border (HP:0000233): Height of the vermilion of the medial part of the lip more than 2 SD below the mean, or apparently reduced height of the vermilion of the lip in the frontal view. The vermilion is the red part of the lips (and confusingly, the vermilion itself is also often referred to as being equivalent the lips). Evidence: TAS. Frequency: Very frequent (HP:0040281). (ORPHA:464288)
- Long philtrum (HP:0000343): Distance between nasal base and midline upper lip vermilion border more than 2 SD above the mean. Alternatively, an apparently increased distance between nasal base and midline upper lip vermilion border. Evidence: TAS. Frequency: Very frequent (HP:0040281). (ORPHA:464288)
- Deeply set eye (HP:0000490): An eye that is more deeply recessed into the plane of the face than is typical. Evidence: TAS. Frequency: Very frequent (HP:0040281). (ORPHA:464288)
- Abnormality of the skeletal system (HP:0000924): An abnormality of the skeletal system. Evidence: TAS. Frequency: Very frequent (HP:0040281). (ORPHA:464288)
- Brachydactyly (HP:0001156): Digits that appear disproportionately short compared to the hand/foot. The word brachydactyly is used here to describe a series distinct patterns of shortened digits (brachydactyly types A-E). This is the sense used here. Evidence: TAS. Frequency: Very frequent (HP:0040281). (ORPHA:464288)
- Intellectual disability (HP:0001249): The term intellectual disability or intellectual developmental disorder is used to describe significantly sub-average intellectual and adaptive functioning based on clinical assessment and as measured by individually administered, appropriately normed, standardized and validated tests of intellectual functioning and adaptive behavior, with onset during the developmental period from infancy through adolescence. Evidence: TAS. Frequency: Very frequent (HP:0040281). (ORPHA:464288)
- Global developmental delay (HP:0001263): A delay in the achievement of motor or mental milestones in the domains of development of a child, including motor skills, speech and language, cognitive skills, and social and emotional skills. This term should only be used to describe children younger than five years of age. Evidence: TAS. Frequency: Very frequent (HP:0040281). (ORPHA:464288)
- Abnormal facial shape (HP:0001999): An abnormal morphology (form) of the face or its components. Evidence: TAS. Frequency: Very frequent (HP:0040281). (ORPHA:464288)
- Short fourth metatarsal (HP:0004689): Short fourth metatarsal bone. Evidence: TAS. Frequency: Very frequent (HP:0040281). (ORPHA:464288)
- Floppy infant (HP:0008947): Floppiness/hypotonia is defined as reduced resistance to passive movement of joints. Physical examination of floppy/hypotonic infants shows head lag, lack of shoulder and elbow muscle contraction on traction response, inability to tighten the shoulder girdle muscles (or slipping through) when held under the axillae, scarf sign (when the arm is pulled to the opposite side, the arm wraps around the neck with the elbow crossing midline), hyperdorsiflexion of the feet, easy apposition of the thumb against the forearm, feet touching the cheek with ease and without discomfort, frog leg position, and inverted U sign on ventral suspension (head, arms, and legs hanging down without elbow or knee flexion and the trunk rounded in a dome shape). Evidence: TAS. Frequency: Very frequent (HP:0040281). (ORPHA:464288)
- Cryptorchidism (HP:0000028): Testis in inguinal canal. That is, absence of one or both testes from the scrotum owing to failure of the testis or testes to descend through the inguinal canal to the scrotum. Evidence: TAS. Frequency: Frequent (HP:0040282). (ORPHA:464288)
- Gingival overgrowth (HP:0000212): Hyperplasia of the gingiva (that is, a thickening of the soft tissue overlying the alveolar ridge. The degree of thickening ranges from involvement of the interdental papillae alone to gingival overgrowth covering the entire tooth crown. Evidence: TAS. Frequency: Frequent (HP:0040282). (ORPHA:464288)
- Hypertelorism (HP:0000316): Interpupillary distance more than 2 SD above the mean (alternatively, the appearance of an increased interpupillary distance or widely spaced eyes). Evidence: TAS. Frequency: Frequent (HP:0040282). (ORPHA:464288)
- Depressed nasal ridge (HP:0000457): Lack of prominence of the nose resulting from a posteriorly-placed nasal ridge. Evidence: TAS. Frequency: Frequent (HP:0040282). (ORPHA:464288)
- Anteverted nares (HP:0000463): Anteriorly-facing nostrils viewed with the head in the Frankfurt horizontal and the eyes of the observer level with the eyes of the subject. This gives the appearance of an upturned nose (upturned nasal tip). Evidence: TAS. Frequency: Frequent (HP:0040282). (ORPHA:464288)
- Short neck (HP:0000470): Diminished length of the neck. Evidence: TAS. Frequency: Frequent (HP:0040282). (ORPHA:464288)
- Strabismus (HP:0000486): A misalignment of the eyes so that the visual axes deviate from bifoveal fixation. The classification of strabismus may be based on a number of features including the relative position of the eyes, whether the deviation is latent or manifest, intermittent or constant, concomitant or otherwise and according to the age of onset and the relevance of any associated refractive error. Evidence: TAS. Frequency: Frequent (HP:0040282). (ORPHA:464288)
- Eczematoid dermatitis (HP:0000964): Eczema is a form of dermatitis that is characterized by scaly, pruritic, erythematous lesions located on flexural surfaces. Evidence: TAS. Frequency: Frequent (HP:0040282). (ORPHA:464288)
- Seizure (HP:0001250): A seizure is an intermittent abnormality of nervous system physiology characterized by a transient occurrence of signs and/or symptoms due to abnormal excessive or synchronous neuronal activity in the brain. Evidence: TAS. Frequency: Frequent (HP:0040282). (ORPHA:464288)
- Mild intellectual disability (HP:0001256): Mild intellectual disability (ID) is defined as a type of ID characterized by mildly sub-average adaptive functioning and intellectual functioning, with an intelligence quotient (IQ) the range of 50-69. Evidence: TAS. Frequency: Frequent (HP:0040282). (ORPHA:464288)
- Specific learning disability (HP:0001328): Impairment of certain skills such as reading or writing, coordination, self-control, or attention that interfere with the ability to learn. The impairment is not related to a global deficiency of intelligence. Evidence: TAS. Frequency: Frequent (HP:0040282). (ORPHA:464288)
- Obesity (HP:0001513): Accumulation of substantial excess body fat. Evidence: TAS. Frequency: Frequent (HP:0040282). (ORPHA:464288)
- Severe intellectual disability (HP:0010864): Severe intellectual disability (ID) is defined as a type of ID characterized by severely sub-average adaptive functioning and intellectual functioning, with an intelligence quotient (IQ) the range of 20-34. Evidence: TAS. Frequency: Frequent (HP:0040282). (ORPHA:464288)
- Prominent forehead (HP:0011220): Forward prominence of the entire forehead, due to protrusion of the frontal bone. Evidence: TAS. Frequency: Frequent (HP:0040282). (ORPHA:464288)
- Flat face (HP:0012368): Absence of concavity or convexity of the face when viewed in profile. Evidence: TAS. Frequency: Frequent (HP:0040282). (ORPHA:464288)
- Abnormal brain morphology (HP:0012443): A structural abnormality of the brain, which has as its parts the forebrain, midbrain, and hindbrain. Evidence: TAS. Frequency: Frequent (HP:0040282). (ORPHA:464288)
- Vesicoureteral reflux (HP:0000076): Abnormal (retrograde) movement of urine from the bladder into ureters or kidneys related to inadequacy of the valvular mechanism at the ureterovesicular junction or other causes. Evidence: TAS. Frequency: Occasional (HP:0040283). (ORPHA:464288)
- Renal hypoplasia (HP:0000089): Hypoplasia of the kidney. Evidence: TAS. Frequency: Occasional (HP:0040283). (ORPHA:464288)
- Microcephaly (HP:0000252): Head circumference below 2 standard deviations below the mean for age and gender. Evidence: TAS. Frequency: Occasional (HP:0040283). (ORPHA:464288)
- Retrognathia (HP:0000278): An abnormality in which the mandible is mislocalised posteriorly. Evidence: TAS. Frequency: Occasional (HP:0040283). (ORPHA:464288)
- Preauricular skin tag (HP:0000384): A rudimentary tag of skin often containing ear tissue including a core of cartilage and located just anterior to the auricle (outer part of the ear). Evidence: TAS. Frequency: Occasional (HP:0040283). (ORPHA:464288)
- Sensorineural hearing impairment (HP:0000407): A type of hearing impairment in one or both ears related to an abnormal functionality of the cochlear nerve. Evidence: TAS. Frequency: Occasional (HP:0040283). (ORPHA:464288)
- Coloboma (HP:0000589): A developmental defect characterized by a cleft of some portion of the eye or ocular adnexa. Evidence: TAS. Frequency: Occasional (HP:0040283). (ORPHA:464288)
- Blue sclerae (HP:0000592): An abnormal bluish coloration of the sclera. Evidence: TAS. Frequency: Occasional (HP:0040283). (ORPHA:464288)
- Dacryocystitis (HP:0000620): Inflammation of the nasolacrimal sac. Evidence: TAS. Frequency: Occasional (HP:0040283). (ORPHA:464288)
- Abnormality of the endocrine system (HP:0000818): An abnormality of the endocrine system. Evidence: TAS. Frequency: Occasional (HP:0040283). (ORPHA:464288)
- Pseudohypoparathyroidism (HP:0000852): A condition characterized by resistance to the action of parathyroid hormone, in which there is hypocalcemia, hyperphosphatemia, and (appropriately) high levels of parathyroid hormone. Evidence: TAS. Frequency: Occasional (HP:0040283). (ORPHA:464288)
- Laryngomalacia (HP:0001601): Laryngomalacia is a congenital abnormality of the laryngeal cartilage in which the cartilage is floppy and prolapses over the larynx during inspiration. Evidence: TAS. Frequency: Occasional (HP:0040283). (ORPHA:464288)
- Hypoplasia of the corpus callosum (HP:0002079): Underdevelopment of the corpus callosum. Evidence: TAS. Frequency: Occasional (HP:0040283). (ORPHA:464288)
- Moderate intellectual disability (HP:0002342): Moderate intellectual disability (ID) is defined as a type of ID characterized by moderately sub-average adaptive functioning and intellectual functioning, with an intelligence quotient (IQ) the range of 35-49. Evidence: TAS. Frequency: Occasional (HP:0040283). (ORPHA:464288)
- Patellar hypoplasia (HP:0003065): Underdevelopment of the patella. Evidence: TAS. Frequency: Occasional (HP:0040283). (ORPHA:464288)
- Thick corpus callosum (HP:0007074): Increased vertical dimension of the corpus callosum. This feature can be visualized by sagittal sections on magnetic resonance tomography imaging of the brain. Evidence: TAS. Frequency: Occasional (HP:0040283). (ORPHA:464288)
- Sleep apnea (HP:0010535): An intermittent cessation of airflow at the mouth and nose during sleep is known as sleep apnea. Apneas that last at least 10 seconds are considered significant, but individuals with sleep apnea may experience apneas lasting from 20 seconds up to 2 or 3 minutes. Patients may have up to 15 events per hour of sleep. Evidence: TAS. Frequency: Occasional (HP:0040283). (ORPHA:464288)
- Feeding difficulties (HP:0011968): Impaired ability to eat related to problems gathering food and getting ready to suck, chew, or swallow it. Evidence: TAS. Frequency: Occasional (HP:0040283). (ORPHA:464288)
- Abnormal conus terminalis morphology (HP:0031938): Any structural anomaly of the conus terminalis, which is the distal bulbous part of the spinal cord at the location where the spinal cord tapers and ends (usually between the L1 and L2 lumbar vertebrae). Evidence: TAS. Frequency: Occasional (HP:0040283). (ORPHA:464288)
These phenotypes are associated with the disease Short stature-brachydactyly-obesity-global developmental delay syndrome (ORPHA:464288).